Phenotypes associated with the disease sulfhemoglobinemia, congenital (OMIM:185460):
- Abnormality of blood and blood-forming tissues (HP:0001871): An abnormality of the hematopoietic system. Evidence: IEA. (OMIM:185460)
- Cyanosis (HP:0000961): Bluish discoloration of the skin and mucosa due to poor circulation or inadequate oxygenation of arterial or capillary blood. Evidence: IEA. (OMIM:185460)
- Autosomal dominant inheritance (HP:0000006): A mode of inheritance that is observed for traits related to a gene encoded on one of the autosomes (i.e., the human chromosomes 1-22) in which a trait manifests in heterozygotes. In the context of medical genetics, an autosomal dominant disorder is caused when a single copy of the mutant allele is present. Males and females are affected equally, and can both transmit the disorder with a risk of 50% for each child of inheriting the mutant allele. Evidence: IEA. (OMIM:185460)